- Depression (HP:0000716): Frequently experiencing feelings of being down, miserable, and/or hopeless; struggling to recover from these moods; having a pessimistic outlook on the future; feeling a pervasive sense of shame; having a low self-worth; experiencing thoughts of suicide and engaging in suicidal behavior. Evidence: PCS. Frequency: 3/3. (PMID:26903630)
- Early chronotype (HP:0031873): A tendency towards rising very early in the morning and going to bed early in the evening. Evidence: PCS. Frequency: 3/3. (PMID:26903630)
- Autosomal dominant inheritance (HP:0000006): A mode of inheritance that is observed for traits related to a gene encoded on one of the autosomes (i.e., the human chromosomes 1-22) in which a trait manifests in heterozygotes. In the context of medical genetics, an autosomal dominant disorder is caused when a single copy of the mutant allele is present. Males and females are affected equally, and can both transmit the disorder with a risk of 50% for each child of inheriting the mutant allele. Evidence: PCS. (PMID:26903630)
These phenotypes are associated with the disease advanced sleep phase syndrome 3 (OMIM:616882).